- Everted lower lip vermilion (HP:0000232): An abnormal configuration of the lower lip such that it is turned outward i.e., everted, with the Inner aspect of the lower lip vermilion (normally opposing the teeth) being visible in a frontal view. Evidence: TAS. Frequency: Very frequent (HP:0040281). (ORPHA:181)
- Depressed nasal ridge (HP:0000457): Lack of prominence of the nose resulting from a posteriorly-placed nasal ridge. Evidence: TAS. Frequency: Very frequent (HP:0040281). (ORPHA:181)
- Delayed eruption of teeth (HP:0000684): Delayed tooth eruption, which can be defined as tooth eruption more than 2 SD beyond the mean eruption age. Evidence: TAS. Frequency: Very frequent (HP:0040281). (ORPHA:181)
- Microdontia (HP:0000691): Decreased size of the teeth, which can be defined as a mesiodistal tooth diameter (width) more than 2 SD below mean. Alternatively, an apparently decreased maximum width of tooth. Evidence: TAS. Frequency: Very frequent (HP:0040281). (ORPHA:181)
- Hypohidrosis (HP:0000966): Abnormally diminished capacity to sweat. Evidence: TAS. Frequency: Very frequent (HP:0040281). (ORPHA:181)
- Sparse body hair (HP:0002231): Sparseness of the body hair. Evidence: TAS. Frequency: Very frequent (HP:0040281). (ORPHA:181)
- Sparse hair (HP:0008070): Reduced density of hairs. Evidence: TAS. Frequency: Very frequent (HP:0040281). (ORPHA:181)
- Everted upper lip vermilion (HP:0010803): Inner aspect of the upper lip vermilion (normally apposing the teeth) visible in a frontal view, i.e., the presence of an everted upper lip. Evidence: TAS. Frequency: Very frequent (HP:0040281). (ORPHA:181)
- Aplasia/Hypoplasia of the eyebrow (HP:0100840): Absence or underdevelopment of the eyebrow. Evidence: TAS. Frequency: Very frequent (HP:0040281). (ORPHA:181)
- Frontal bossing (HP:0002007): Bilateral bulging of the lateral frontal bone prominences with relative sparing of the midline. Evidence: TAS. Frequency: Frequent (HP:0040282). (ORPHA:181)
- Hypertension (HP:0000822): The presence of chronic increased pressure in the systemic arterial system. Evidence: TAS. Frequency: Occasional (HP:0040283). (ORPHA:181)
- Anterior hypopituitarism (HP:0000830): A condition of reduced function of the anterior pituitary gland characterized by decreased secretion of one or more of the pituitary hormones growth hormone, thyroid-stimulating hormone, adrenocorticotropic hormone, prolactin, luteinizing hormone, and follicle-stimulating hormone. Evidence: TAS. Frequency: Occasional (HP:0040283). (ORPHA:181)
- Short distal phalanx of finger (HP:0009882): Short distance from the end of the finger to the most distal interphalangeal crease or the distal interphalangeal joint flexion point. That is, hypoplasia of one or more of the distal phalanx of finger. Evidence: TAS. Frequency: Occasional (HP:0040283). (ORPHA:181)
- Type I diabetes mellitus (HP:0100651): A chronic condition in which the pancreas produces little or no insulin. Type I diabetes mellitus is manifested by the sudden onset of severe hyperglycemia with rapid progression to diabetic ketoacidosis unless treated with insulin. Evidence: TAS. Frequency: Occasional (HP:0040283). (ORPHA:181)
These phenotypes are associated with the disease X-linked hypohidrotic ectodermal dysplasia (ORPHA:181).